Phenotypes associated with the disease IgG4-related aortitis (ORPHA:449400):
- Increased circulating immunoglobulin concentration (HP:0010702): An increased level of gamma globulin (immunoglobulin) in the blood. Evidence: TAS. Frequency: Very frequent (HP:0040281). (ORPHA:449400)
- Increased circulating IgG4 concentration (HP:0032300): An abnormally increased concentration of the IgG4 subtype in the blood circulation. Evidence: TAS. Frequency: Very frequent (HP:0040281). (ORPHA:449400)
- Weight loss (HP:0001824): Reduction of total body weight. Evidence: TAS. Frequency: Frequent (HP:0040282). (ORPHA:449400)
- Fever (HP:0001945): Body temperature elevated above the normal range. Evidence: TAS. Frequency: Frequent (HP:0040282). (ORPHA:449400)
- Abdominal pain (HP:0002027): An unpleasant sensation characterized by physical discomfort (such as pricking, throbbing, or aching) and perceived to originate in the abdomen. Evidence: TAS. Frequency: Frequent (HP:0040282). (ORPHA:449400)
- Asthma (HP:0002099): Asthma is characterized by increased responsiveness of the tracheobronchial tree to multiple stimuli, leading to narrowing of the air passages with resultant dyspnea, cough, and wheezing. Evidence: TAS. Frequency: Frequent (HP:0040282). (ORPHA:449400)
- Autoimmunity (HP:0002960): The occurrence of an immune reaction against the organism's own cells or tissues. Evidence: TAS. Frequency: Frequent (HP:0040282). (ORPHA:449400)
- Increased circulating IgE concentration (HP:0003212): An abnormally increased overall level of immunoglobulin E in blood. Evidence: TAS. Frequency: Frequent (HP:0040282). (ORPHA:449400)
- Low back pain (HP:0003419): An unpleasant sensation characterized by physical discomfort (such as pricking, throbbing, or aching) localized to the lower back. Evidence: TAS. Frequency: Frequent (HP:0040282). (ORPHA:449400)
- Antinuclear antibody positivity (HP:0003493): The presence of autoantibodies in the serum that react against nuclei or nuclear components. Evidence: TAS. Frequency: Frequent (HP:0040282). (ORPHA:449400)
- Elevated erythrocyte sedimentation rate (HP:0003565): An increased erythrocyte sedimentation rate (ESR). The ESR is a test that measures the distance that erythrocytes have fallen after one hour in a vertical column of anticoagulated blood under the influence of gravity. The ESR is a nonspecific finding. An elevation may indicate inflammation or may be caused by any condition that elevates fibrinogen. Evidence: TAS. Frequency: Frequent (HP:0040282). (ORPHA:449400)
- Elevated circulating C-reactive protein concentration (HP:0011227): The concentration of C-reactive protein in the blood circulation is above the upper limit of normal. Evidence: TAS. Frequency: Frequent (HP:0040282). (ORPHA:449400)
- Allergy (HP:0012393): An allergy is an immune response or reaction to substances that are usually not harmful. Evidence: TAS. Frequency: Frequent (HP:0040282). (ORPHA:449400)
- Increased inflammatory response (HP:0012649): A abnormal increase in the inflammatory response to injury or infection. Evidence: TAS. Frequency: Frequent (HP:0040282). (ORPHA:449400)
- Thoracic aortic aneurysm (HP:0012727): An abnormal localized widening (dilatation) of the thoracic aorta. Evidence: TAS. Frequency: Frequent (HP:0040282). (ORPHA:449400)
- Severely increased total eosinophil count (HP:0032061): Severe increase in circulating eosinophils, usually characterized as more than 1500 eosinophils per microlitre. Evidence: TAS. Frequency: Frequent (HP:0040282). (ORPHA:449400)
- Hydronephrosis (HP:0000126): Severe distention of the kidney with dilation of the renal pelvis and calices. Evidence: TAS. Frequency: Occasional (HP:0040283). (ORPHA:449400)
- Aortic dissection (HP:0002647): Aortic dissection refers to a tear in the intimal layer of the aorta causing a separation between the intima and the medial layers of the aorta. Evidence: TAS. Frequency: Occasional (HP:0040283). (ORPHA:449400)
- Reduced circulating complement concentration (HP:0004431): An immunodeficiency defined by the absent or suboptimal functioning of one of the complement system proteins. Evidence: TAS. Frequency: Occasional (HP:0040283). (ORPHA:449400)
- Ascending tubular aorta aneurysm (HP:0004970): An abnormal localized widening (dilatation) of the tubular part of the ascending aorta. Evidence: TAS. Frequency: Occasional (HP:0040283). (ORPHA:449400)
- Intestinal obstruction (HP:0005214): Blockage or impairment of the normal flow of the contents of the intestine towards the anal canal. Evidence: TAS. Frequency: Occasional (HP:0040283). (ORPHA:449400)
- Abnormal aortic arch morphology (HP:0012303): An anomaly of the arch of aorta. Evidence: TAS. Frequency: Occasional (HP:0040283). (ORPHA:449400)
- Dilated left subclavian artery (HP:0031252): Abnormally increased caliber of the left subclavian artery. Evidence: TAS. Frequency: Occasional (HP:0040283). (ORPHA:449400)
- Cytoplasmic antineutrophil antibody positivity (HP:0032230): The presence of autoantibodies in the serum that react against proteins predominantly expressed in cytoplasmic granules of neutrophils. Evidence: TAS. Frequency: Occasional (HP:0040283). (ORPHA:449400)
- Abnormal common carotid artery morphology (HP:0430021): An abnormality of the common carotid arteries, which provide the arterial supply to the head and neck and give rise to the internal carotid artery and the external carotid artery. Evidence: TAS. Frequency: Occasional (HP:0040283). (ORPHA:449400)